- Hypogonadotropic hypogonadism (HP:0000044): Hypogonadotropic hypogonadism is characterized by reduced function of the gonads (testes in males or ovaries in females) and results from the absence of the gonadal stimulating pituitary hormones: follicle stimulating hormone (FSH) and luteinizing hormone (LH). Evidence: TAS. Frequency: Frequent (HP:0040282). (ORPHA:353298)
- Thin upper lip vermilion (HP:0000219): Height of the vermilion of the upper lip in the midline more than 2 SD below the mean. Alternatively, an apparently reduced height of the vermilion of the upper lip in the frontal view (subjective). Evidence: TAS. Frequency: Frequent (HP:0040282). (ORPHA:353298)
- Microcephaly (HP:0000252): Head circumference below 2 standard deviations below the mean for age and gender. Evidence: TAS. Frequency: Frequent (HP:0040282). (ORPHA:353298)
- Hypertelorism (HP:0000316): Interpupillary distance more than 2 SD above the mean (alternatively, the appearance of an increased interpupillary distance or widely spaced eyes). Evidence: TAS. Frequency: Frequent (HP:0040282). (ORPHA:353298)
- Long philtrum (HP:0000343): Distance between nasal base and midline upper lip vermilion border more than 2 SD above the mean. Alternatively, an apparently increased distance between nasal base and midline upper lip vermilion border. Evidence: TAS. Frequency: Frequent (HP:0040282). (ORPHA:353298)
- Recurrent otitis media (HP:0000403): Increased susceptibility to otitis media, as manifested by recurrent episodes of otitis media. Evidence: TAS. Frequency: Frequent (HP:0040282). (ORPHA:353298)
- Underdeveloped nasal alae (HP:0000430): Thinned, deficient, or excessively arched ala nasi. Evidence: TAS. Frequency: Frequent (HP:0040282). (ORPHA:353298)
- Narrow nasal bridge (HP:0000446): Decreased width of the bony bridge of the nose. Evidence: TAS. Frequency: Frequent (HP:0040282). (ORPHA:353298)
- Retinal dystrophy (HP:0000556): Retinal dystrophy is an abnormality of the retina associated with a hereditary process. Retinal dystrophies are defined by their predominantly monogenic inheritance and they are frequently associated with loss or dysfunction of photoreceptor cells as a primary or secondary event. Evidence: TAS. Frequency: Frequent (HP:0040282). (ORPHA:353298)
- Long palpebral fissure (HP:0000637): Distance between medial and lateral canthi is more than two standard deviations above the mean for age (objective); or, apparently increased length of the palpebral fissures. Evidence: TAS. Frequency: Frequent (HP:0040282). (ORPHA:353298)
- Eczematoid dermatitis (HP:0000964): Eczema is a form of dermatitis that is characterized by scaly, pruritic, erythematous lesions located on flexural surfaces. Evidence: TAS. Frequency: Frequent (HP:0040282). (ORPHA:353298)
- Brachydactyly (HP:0001156): Digits that appear disproportionately short compared to the hand/foot. The word brachydactyly is used here to describe a series distinct patterns of shortened digits (brachydactyly types A-E). This is the sense used here. Evidence: TAS. Frequency: Frequent (HP:0040282). (ORPHA:353298)
- Generalized hypotonia (HP:0001290): Generalized muscular hypotonia (abnormally low muscle tone). Evidence: TAS. Frequency: Frequent (HP:0040282). (ORPHA:353298)
- Hepatosplenomegaly (HP:0001433): Simultaneous enlargement of the liver and spleen. Evidence: TAS. Frequency: Frequent (HP:0040282). (ORPHA:353298)
- Intrauterine growth retardation (HP:0001511): An abnormal restriction of fetal growth with fetal weight below the tenth percentile for gestational age. Evidence: TAS. Frequency: Frequent (HP:0040282). (ORPHA:353298)
- Hyperconvex nail (HP:0001795): When viewed on end (with the digit tip pointing toward the examiner's eye) the curve of the nail forms a tighter curve of convexity. Evidence: TAS. Frequency: Frequent (HP:0040282). (ORPHA:353298)
- Short toe (HP:0001831): A toe that appears disproportionately short compared to the foot. Evidence: TAS. Frequency: Frequent (HP:0040282). (ORPHA:353298)
- Increased total eosinophil count (HP:0001880): Increased count of eosinophils in the blood. Evidence: TAS. Frequency: Frequent (HP:0040282). (ORPHA:353298)
- Hypoplasia of the corpus callosum (HP:0002079): Underdevelopment of the corpus callosum. Evidence: TAS. Frequency: Frequent (HP:0040282). (ORPHA:353298)
- Moderate intellectual disability (HP:0002342): Moderate intellectual disability (ID) is defined as a type of ID characterized by moderately sub-average adaptive functioning and intellectual functioning, with an intelligence quotient (IQ) the range of 35-49. Evidence: TAS. Frequency: Frequent (HP:0040282). (ORPHA:353298)
- Spondyloepiphyseal dysplasia (HP:0002655): A disorder of bone growth affecting the vertebrae and the ends of the long bones (epiphyses). Evidence: TAS. Frequency: Frequent (HP:0040282). (ORPHA:353298)
- Epiphyseal dysplasia (HP:0002656). Evidence: TAS. Frequency: Frequent (HP:0040282). (ORPHA:353298)
- Downturned corners of mouth (HP:0002714): A morphological abnormality of the mouth in which the angle of the mouth is downturned. The oral commissures are positioned inferior to the midline labial fissure. Evidence: TAS. Frequency: Frequent (HP:0040282). (ORPHA:353298)
- Lymphadenopathy (HP:0002716): Enlargement (swelling) of a lymph node. Evidence: TAS. Frequency: Frequent (HP:0040282). (ORPHA:353298)
- Hip contracture (HP:0003273): Lack of full passive range of motion (restrictions in flexion, extension, or other movements) of the hip joint resulting from structural changes of non-bony tissues, such as muscles, tendons, ligaments, joint capsules and/or skin. Evidence: TAS. Frequency: Frequent (HP:0040282). (ORPHA:353298)
- Clinodactyly of the 5th finger (HP:0004209): Clinodactyly refers to a bending or curvature of the fifth finger in the radial direction (i.e., towards the 4th finger). Evidence: TAS. Frequency: Frequent (HP:0040282). (ORPHA:353298)
- Decreased circulating immunoglobulin concentration (HP:0004313): An abnormally decreased level of immunoglobulin in blood. Evidence: TAS. Frequency: Frequent (HP:0040282). (ORPHA:353298)
- Short stature (HP:0004322): A height below that which is expected according to age and gender norms. Although there is no universally accepted definition of short stature, many refer to "short stature" as height more than 2 standard deviations below the mean for age and gender (or below the 3rd percentile for age and gender dependent norms). Evidence: TAS. Frequency: Frequent (HP:0040282). (ORPHA:353298)
- Biconvex vertebral bodies (HP:0004625): Presence of abnormal convexity of the upper and lower end plates of the vertebrae, i.e., an exaggerated bulging out of the upper and lower vertebral end plates. Evidence: TAS. Frequency: Frequent (HP:0040282). (ORPHA:353298)
- Irregular capital femoral epiphysis (HP:0005041): Irregular surface of the normally relatively smooth capital femoral epiphysis. Evidence: TAS. Frequency: Frequent (HP:0040282). (ORPHA:353298)
- Recurrent pneumonia (HP:0006532): An increased susceptibility to pneumonia as manifested by a history of recurrent episodes of pneumonia. Evidence: TAS. Frequency: Frequent (HP:0040282). (ORPHA:353298)
- Bilateral single transverse palmar creases (HP:0007598): The distal and proximal transverse palmar creases are merged into a single transverse palmar crease on both hands. Evidence: TAS. Frequency: Frequent (HP:0040282). (ORPHA:353298)
- Broad femoral head (HP:0008804): Increased width of the femoral head. Evidence: TAS. Frequency: Frequent (HP:0040282). (ORPHA:353298)
- Delayed proximal femoral epiphyseal ossification (HP:0008828): Developmental delay of ossification of the proximal epiphysis of the femur. Evidence: TAS. Frequency: Frequent (HP:0040282). (ORPHA:353298)
- Postnatal growth retardation (HP:0008897): Slow or limited growth after birth. Evidence: TAS. Frequency: Frequent (HP:0040282). (ORPHA:353298)
- Prominent eyelashes (HP:0011231): Eyelashes that draw the attention of the viewer due to increased density and/or length and/or curl without meeting the criteria of trichomegaly. Evidence: TAS. Frequency: Frequent (HP:0040282). (ORPHA:353298)
- Hippocampal atrophy (HP:0410170): Partial or complete wasting (loss) of hippocampus tissue that was once present. Evidence: TAS. Frequency: Frequent (HP:0040282). (ORPHA:353298)
- Noncompaction cardiomyopathy (HP:0012817): A type of cardiomyopathy characterized anatomically by deep trabeculations in the ventricular wall, which define recesses communicating with the main ventricular chamber. Evidence: TAS. Frequency: Very rare (HP:0040284). (ORPHA:353298)
These phenotypes are associated with the disease Roifman syndrome (ORPHA:353298).
The following phenotypes are NOT associated with this disease:
- Decreased T cell activation (HP:0005419): Decreased or impaired activation of T cells in response to a mitogen, cytokine, chemokine, cellular ligand, or an antigen for which it is specific. Evidence: TAS. (ORPHA:353298)